- Microcephaly (HP:0000252): Head circumference below 2 standard deviations below the mean for age and gender. Evidence: PCS. Frequency: 2/5. (PMID:31607425)
- Status epilepticus (HP:0002133): Status epilepticus is a type of prolonged seizure resulting either from the failure of the mechanisms responsible for seizure termination or from the initiation of mechanisms which lead to abnormally prolonged seizures (after time point t1). It is a condition that can have long-term consequences (after time point t2), including neuronal death, neuronal injury, and alteration of neuronal networks, depending on the type and duration of seizures. Evidence: PCS. Frequency: 3/5. (PMID:31607425)
- Absent speech (HP:0001344): Complete lack of development of speech and language abilities. Evidence: PCS. Frequency: 2/5. (PMID:31607425)
- Short stature (HP:0004322): A height below that which is expected according to age and gender norms. Although there is no universally accepted definition of short stature, many refer to "short stature" as height more than 2 standard deviations below the mean for age and gender (or below the 3rd percentile for age and gender dependent norms). Evidence: PCS. Frequency: 5/5. (PMID:31607425)
- Delayed ability to walk (HP:0031936): A failure to achieve the ability to walk at an appropriate developmental stage. Most children learn to walk in a series of stages, and learn to walk short distances independently between 12 and 15 months. Evidence: PCS. Frequency: 3/5. (PMID:31607425)
- Seizure (HP:0001250): A seizure is an intermittent abnormality of nervous system physiology characterized by a transient occurrence of signs and/or symptoms due to abnormal excessive or synchronous neuronal activity in the brain. Evidence: PCS. Frequency: 3/5. (PMID:31607425)
- Gait ataxia (HP:0002066): A type of ataxia characterized by the impairment of the ability to coordinate the movements required for normal walking. Gait ataxia is characteirzed by a wide-based staggering gait with a tendency to fall. Evidence: PCS. Frequency: 1/5. (PMID:31607425)
- Global developmental delay (HP:0001263): A delay in the achievement of motor or mental milestones in the domains of development of a child, including motor skills, speech and language, cognitive skills, and social and emotional skills. This term should only be used to describe children younger than five years of age. Evidence: PCS. Frequency: 5/5. (PMID:31607425)
- Generalized hypotonia (HP:0001290): Generalized muscular hypotonia (abnormally low muscle tone). Evidence: PCS. Frequency: 5/5. (PMID:31607425)
- Motor delay (HP:0001270): A type of Developmental delay characterized by a delay in acquiring motor skills. Evidence: PCS. Frequency: 5/5. (PMID:31607425)
- Severe intellectual disability (HP:0010864): Severe intellectual disability (ID) is defined as a type of ID characterized by severely sub-average adaptive functioning and intellectual functioning, with an intelligence quotient (IQ) the range of 20-34. Evidence: PCS. Frequency: 5/5. (PMID:31607425)
- Aggressive behavior (HP:0000718): Behavior or an act aimed at harming a person, animal, or physical property (e.g., acts of physical violence; shouting, swearing, and using harsh language; slashing someone's tires). Evidence: PCS. Frequency: 3/5. (PMID:31607425)
- Autosomal recessive inheritance (HP:0000007): A mode of inheritance that is observed for traits related to a gene encoded on one of the autosomes (i.e., the human chromosomes 1-22) in which a trait manifests in individuals with two pathogenic alleles, either homozygotes (two copies of the same mutant allele) or compound heterozygotes (whereby each copy of a gene has a distinct mutant allele). Evidence: PCS. (PMID:31607425)
- Visual impairment (HP:0000505): Visual impairment (or vision impairment) is vision loss (of a person) to such a degree as to qualify as an additional support need through a significant limitation of visual capability resulting from either disease, trauma, or congenital or degenerative conditions that cannot be corrected by conventional means, such as refractive correction, medication, or surgery. Evidence: PCS. Frequency: 1/5. (PMID:31607425)
- Attention deficit hyperactivity disorder (HP:0007018): Attention deficit hyperactivity disorder (ADHD) manifests at age 2-3 years or by first grade at the latest. The main symptoms are distractibility, impulsivity, hyperactivity, and often trouble organizing tasks and projects, difficulty going to sleep, and social problems from being aggressive, loud, or impatient. Evidence: PCS. Frequency: 3/5. (PMID:31607425)
These phenotypes are associated with the disease intellectual developmental disorder with short stature and behavioral abnormalities (OMIM:618687).